- Abnormality of metabolism/homeostasis (HP:0001939). Evidence: IEA. (OMIM:314900)
- X-linked inheritance (HP:0001417): A mode of inheritance that is observed for traits related to a gene encoded on the X chromosome. Evidence: IEA. (OMIM:314900)
These phenotypes are associated with the disease XM SYSTEM (OMIM:314900).